Phenotypes associated with the disease DERMATOGLYPHICS--FINGERPRINT PATTERN (OMIM:125590):
- Abnormal dermatoglyphics (HP:0007477): An abnormality of dermatoglyphs (fingerprints), which are present on fingers, palms, toes, and soles. Evidence: TAS. (OMIM:125590)
- Autosomal dominant inheritance (HP:0000006): A mode of inheritance that is observed for traits related to a gene encoded on one of the autosomes (i.e., the human chromosomes 1-22) in which a trait manifests in heterozygotes. In the context of medical genetics, an autosomal dominant disorder is caused when a single copy of the mutant allele is present. Males and females are affected equally, and can both transmit the disorder with a risk of 50% for each child of inheriting the mutant allele. Evidence: TAS. (OMIM:125590)